- Horseshoe kidney (HP:0000085): A connection of the right and left kidney by an isthmus of functioning renal parenchyma or fibrous tissue that crosses the midline. Evidence: TAS. Frequency: Very frequent (HP:0040281). (ORPHA:959)
- Abnormal thumb morphology (HP:0001172): An abnormal structure of the first digit of the hand. Evidence: TAS. Frequency: Very frequent (HP:0040281). (ORPHA:959)
- Abnormal morphology of the radius (HP:0002818): An abnormality of the radius. Evidence: TAS. Frequency: Very frequent (HP:0040281). (ORPHA:959)
- Renal malrotation (HP:0004712): An abnormality of the normal developmental rotation of the kidney leading to an abnormal orientation of the kidney. Evidence: TAS. Frequency: Very frequent (HP:0040281). (ORPHA:959)
- Crossed fused renal ectopia (HP:0004736): A developmental anomaly in which the kidneys are fused and localized on the same side of the midline. This anomaly is thought to result from disruption of the normal embryologic migration of the kidneys. Evidence: TAS. Frequency: Very frequent (HP:0040281). (ORPHA:959)
- Aplasia/Hypoplasia of the radius (HP:0006501): A small/hypoplastic or absent/aplastic radius. Evidence: TAS. Frequency: Very frequent (HP:0040281). (ORPHA:959)
- Short distal phalanx of the thumb (HP:0009650): Hypoplastic (short) distal phalanx of the thumb. Evidence: TAS. Frequency: Very frequent (HP:0040281). (ORPHA:959)
- Short thumb (HP:0009778): Hypoplasia (congenital reduction in size) of the thumb. Evidence: TAS. Frequency: Very frequent (HP:0040281). (ORPHA:959)
- Bladder diverticulum (HP:0000015): Diverticulum (sac or pouch) in the wall of the urinary bladder. Evidence: TAS. Frequency: Frequent (HP:0040282). (ORPHA:959)
- Conductive hearing impairment (HP:0000405): An abnormality of vibrational conductance of sound to the inner ear leading to impairment of sensory perception of sound. Evidence: TAS. Frequency: Frequent (HP:0040282). (ORPHA:959)
- Sensorineural hearing impairment (HP:0000407): A type of hearing impairment in one or both ears related to an abnormal functionality of the cochlear nerve. Evidence: TAS. Frequency: Frequent (HP:0040282). (ORPHA:959)
- Strabismus (HP:0000486): A misalignment of the eyes so that the visual axes deviate from bifoveal fixation. The classification of strabismus may be based on a number of features including the relative position of the eyes, whether the deviation is latent or manifest, intermittent or constant, concomitant or otherwise and according to the age of onset and the relevance of any associated refractive error. Evidence: TAS. Frequency: Frequent (HP:0040282). (ORPHA:959)
- Visual impairment (HP:0000505): Visual impairment (or vision impairment) is vision loss (of a person) to such a degree as to qualify as an additional support need through a significant limitation of visual capability resulting from either disease, trauma, or congenital or degenerative conditions that cannot be corrected by conventional means, such as refractive correction, medication, or surgery. Evidence: TAS. Frequency: Frequent (HP:0040282). (ORPHA:959)
- Optic disc coloboma (HP:0000588): A cleft of the optic nerve that extends inferiorly. Evidence: TAS. Frequency: Frequent (HP:0040282). (ORPHA:959)
- Preaxial hand polydactyly (HP:0001177): Supernumerary digits located at the radial side of the hand. Polydactyly (supernumerary digits) involving the thumb occurs in many distinct forms of high variability and severity. Ranging from fleshy nubbins over varying degrees of partial duplication/splitting to completely duplicated or even triplicated thumbs or preaxial (on the radial side of the hand) supernumerary digits. Evidence: TAS. Frequency: Frequent (HP:0040282). (ORPHA:959)
- Triphalangeal thumb (HP:0001199): A thumb with three phalanges in a single, proximo-distal axis. Thus, this term applies if the thumb has an accessory phalanx, leading to a digit like appearance of the thumb. Evidence: TAS. Frequency: Frequent (HP:0040282). (ORPHA:959)
- Sandal gap (HP:0001852): A widely spaced gap between the first toe (the great toe) and the second toe. Evidence: TAS. Frequency: Frequent (HP:0040282). (ORPHA:959)
- Hypoplasia of the ulna (HP:0003022): Underdevelopment of the ulna. Evidence: TAS. Frequency: Frequent (HP:0040282). (ORPHA:959)
- Radial ray deficiency (HP:0006433): Radial dysplasia, also known as radial longitudinal deficiency, includes radial clubhand and is a disfiguring, and potentially disabling, congenital limb anomaly. The entire upper limb may be involved, although the defect is most evident in the forearm and hand. Affected children suffer a variable degree of hypoplasia or absence of the preaxial skeleton and soft tissues, in particular the thumb, radius, and dorsoradial soft tissues. The hand is usually radially deviated and subluxated off the distal aspect of the ulna, the ulna may be shortened and have a bow-shaped deformity, and there is no true wrist (radiocarpal) joint in Bayne2 type-III and IV radial dysplasia. Evidence: TAS. Frequency: Frequent (HP:0040282). (ORPHA:959)
- Optic disc hypoplasia (HP:0007766): Underdevelopment of the optic disc, that is of the optic nerve head, where ganglion cell axons exit the eye to form the optic nerve. Evidence: TAS. Frequency: Frequent (HP:0040282). (ORPHA:959)
- Renal hypoplasia/aplasia (HP:0008678): Absence or underdevelopment of the kidney. Evidence: TAS. Frequency: Frequent (HP:0040282). (ORPHA:959)
- Broad hallux phalanx (HP:0010059): An increase in width in one or more phalanges of the big toe. Evidence: TAS. Frequency: Frequent (HP:0040282). (ORPHA:959)
- Short hallux (HP:0010109): Underdevelopment (hypoplasia) of the big toe. Evidence: TAS. Frequency: Frequent (HP:0040282). (ORPHA:959)
- Short palpebral fissure (HP:0012745): Distance between the medial and lateral canthi is more than 2 SD below the mean for age (objective); or, apparently reduced length of the palpebral fissures. Evidence: TAS. Frequency: Frequent (HP:0040282). (ORPHA:959)
- Vesicoureteral reflux (HP:0000076): Abnormal (retrograde) movement of urine from the bladder into ureters or kidneys related to inadequacy of the valvular mechanism at the ureterovesicular junction or other causes. Evidence: TAS. Frequency: Occasional (HP:0040283). (ORPHA:959)
- Epicanthus (HP:0000286): A fold of skin starting above the medial aspect of the upper eyelid and arching downward to cover, pass in front of and lateral to the medial canthus. Evidence: TAS. Frequency: Occasional (HP:0040283). (ORPHA:959)
- Hypertelorism (HP:0000316): Interpupillary distance more than 2 SD above the mean (alternatively, the appearance of an increased interpupillary distance or widely spaced eyes). Evidence: TAS. Frequency: Occasional (HP:0040283). (ORPHA:959)
- Microcornea (HP:0000482): A congenital abnormality of the cornea in which the cornea and the anterior segment of the eye are smaller than normal. The horizontal diameter of the cornea does not reach 10 mm even in adulthood. Evidence: TAS. Frequency: Occasional (HP:0040283). (ORPHA:959)
- Ptosis (HP:0000508): The upper eyelid margin is positioned 3 mm or more lower than usual and covers the superior portion of the iris (objective); or, the upper lid margin obscures at least part of the pupil (subjective). Evidence: TAS. Frequency: Occasional (HP:0040283). (ORPHA:959)
- Cataract (HP:0000518): A cataract is an opacity or clouding that develops in the crystalline lens of the eye or in its capsule. Evidence: TAS. Frequency: Occasional (HP:0040283). (ORPHA:959)
- Chorioretinal coloboma (HP:0000567): Absence of a region of the retina, retinal pigment epithelium, and choroid. Evidence: TAS. Frequency: Occasional (HP:0040283). (ORPHA:959)
- Microphthalmia (HP:0000568): A developmental anomaly characterized by abnormal smallness of one or both eyes. Evidence: TAS. Frequency: Occasional (HP:0040283). (ORPHA:959)
- Coloboma (HP:0000589): A developmental defect characterized by a cleft of some portion of the eye or ocular adnexa. Evidence: TAS. Frequency: Occasional (HP:0040283). (ORPHA:959)
- Iris coloboma (HP:0000612): A coloboma of the iris. Evidence: TAS. Frequency: Occasional (HP:0040283). (ORPHA:959)
- Nystagmus (HP:0000639): Rhythmic, involuntary oscillations of one or both eyes related to abnormality in fixation, conjugate gaze, or vestibular mechanisms. Evidence: TAS. Frequency: Occasional (HP:0040283). (ORPHA:959)
- Tetralogy of Fallot (HP:0001636): A congenital cardiac malformation comprising pulmonary stenosis, overriding aorta, ventricular septum defect, and right ventricular hypertrophy. The diagnosis of TOF is made if at least three of the four above mentioned features are present. Evidence: TAS. Frequency: Occasional (HP:0040283). (ORPHA:959)
- Toe syndactyly (HP:0001770): Webbing or fusion of the toes, involving soft parts only or including bone structure. Bony fusions are referred to as "bony" Syndactyly if the fusion occurs in a radio-ulnar axis. Fusions of bones of the toes in a proximo-distal axis are referred to as "Symphalangism". Evidence: TAS. Frequency: Occasional (HP:0040283). (ORPHA:959)
- Talipes (HP:0001883): A deformity of foot and ankle that has different subtypes that are talipes equinovarus, talipes equinovalgus, talipes calcaneovarus and talipes calcaneovalgus. Evidence: TAS. Frequency: Occasional (HP:0040283). (ORPHA:959)
- Aganglionic megacolon (HP:0002251): An abnormality resulting from a lack of intestinal ganglion cells (i.e., an aganglionic section of bowel) that results in bowel obstruction with enlargement of the colon. Evidence: TAS. Frequency: Occasional (HP:0040283). (ORPHA:959)
- Vertebral fusion (HP:0002948): A developmental defect leading to the union of two adjacent vertebrae. Evidence: TAS. Frequency: Occasional (HP:0040283). (ORPHA:959)
- Vertebral segmentation defect (HP:0003422): An abnormality related to a defect of vertebral separation during development. Evidence: TAS. Frequency: Occasional (HP:0040283). (ORPHA:959)
- Short humerus (HP:0005792): Underdevelopment of the humerus. Evidence: TAS. Frequency: Occasional (HP:0040283). (ORPHA:959)
- Finger syndactyly (HP:0006101): Webbing or fusion of the fingers, involving soft parts only or including bone structure. Bony fusions are referred to as "bony" Syndactyly if the fusion occurs in a radio-ulnar axis. Fusions of bones of the fingers in a proximo-distal axis are referred to as "Symphalangism". Evidence: TAS. Frequency: Occasional (HP:0040283). (ORPHA:959)
- Postnatal growth retardation (HP:0008897): Slow or limited growth after birth. Evidence: TAS. Frequency: Occasional (HP:0040283). (ORPHA:959)
These phenotypes are associated with the disease Acro-renal-ocular syndrome (ORPHA:959).